Phenotypes associated with the disease metabolic syndrome X (OMIM:605552):
- Hypertension (HP:0000822): The presence of chronic increased pressure in the systemic arterial system. Evidence: TAS. (OMIM:605552)
- Abdominal obesity (HP:0012743): Excessive fat around the stomach and abdomen. Evidence: TAS. (OMIM:605552)
- Autosomal dominant inheritance (HP:0000006): A mode of inheritance that is observed for traits related to a gene encoded on one of the autosomes (i.e., the human chromosomes 1-22) in which a trait manifests in heterozygotes. In the context of medical genetics, an autosomal dominant disorder is caused when a single copy of the mutant allele is present. Males and females are affected equally, and can both transmit the disorder with a risk of 50% for each child of inheriting the mutant allele. Evidence: TAS. (OMIM:605552)